- Abnormality of the skeletal system (HP:0000924): An abnormality of the skeletal system. Evidence: TAS. Frequency: Occasional (HP:0040283). (ORPHA:57782)
- Skeletal dysplasia (HP:0002652): A general term describing features characterized by abnormal development of bones and connective tissues. Evidence: TAS. Frequency: Occasional (HP:0040283). (ORPHA:57782)
- Bone pain (HP:0002653): An unpleasant sensation characterized by physical discomfort (such as pricking, throbbing, or aching) localized to bone. Evidence: TAS. Frequency: Occasional (HP:0040283). (ORPHA:57782)
- Recurrent fractures (HP:0002757): The repeated occurrence of bone fractures (implying an abnormally increased tendency for fracture). Evidence: TAS. Frequency: Occasional (HP:0040283). (ORPHA:57782)
- Fibrous dysplasia of the bones (HP:0010734): Tumor-like growths that consist of replacement of the medullary bone with fibrous tissue, causing the expansion and weakening of the areas of bone involved. Especially when involving the skull or facial bones, the lesions can cause externally visible deformities. The skull is often, but not necessarily, affected, and any other bone or bones may be involved. Fibrous dysplasia can either effect isolated bones (Monostotic fibrous dysplasia) or also generalized all bones of the body (Polyostotic fibrous dysplasia). Evidence: TAS. Frequency: Very frequent (HP:0040281). (ORPHA:57782)
These phenotypes are associated with the disease Mazabraud syndrome (ORPHA:57782).